Phenotypes associated with the disease NK-cell enteropathy (ORPHA:263665):
- Edema (HP:0000969): An abnormal accumulation of fluid beneath the skin, or in one or more cavities of the body. Evidence: TAS. Frequency: Very frequent (HP:0040281). (ORPHA:263665)
- Lymphoproliferative disorder (HP:0005523). Evidence: TAS. Frequency: Very frequent (HP:0040281). (ORPHA:263665)
- Increased total T cell count (HP:0100828): Abnormal increase in the absolute number of T cells, commonly characterized as CD3+ lymphocytes, per microliter of blood, compared to a reference range for a given sex and age-group. These may include both TCR alpha/beta and gamma/delta T cells. Evidence: TAS. Frequency: Very frequent (HP:0040281). (ORPHA:263665)
- Abdominal pain (HP:0002027): An unpleasant sensation characterized by physical discomfort (such as pricking, throbbing, or aching) and perceived to originate in the abdomen. Evidence: TAS. Frequency: Frequent (HP:0040282). (ORPHA:263665)
- Diarrhea (HP:0002014): Abnormally increased frequency (usually defined as three or more) loose or watery bowel movements a day. Evidence: TAS. Frequency: Occasional (HP:0040283). (ORPHA:263665)
- Constipation (HP:0002019): Infrequent or difficult evacuation of feces. Evidence: TAS. Frequency: Occasional (HP:0040283). (ORPHA:263665)
- Gastroesophageal reflux (HP:0002020): A condition in which the stomach contents leak backwards from the stomach into the esophagus through the lower esophageal sphincter. Evidence: TAS. Frequency: Occasional (HP:0040283). (ORPHA:263665)
- Colonic diverticula (HP:0002253): The presence of multiple diverticula of the colon. Evidence: TAS. Frequency: Occasional (HP:0040283). (ORPHA:263665)
- Hematochezia (HP:0002573): The passage of fresh (red) blood per anus, usually in or with stools. Most rectal bleeding comes from the colon, rectum, or anus. Evidence: TAS. Frequency: Occasional (HP:0040283). (ORPHA:263665)
- Duodenal ulcer (HP:0002588): An erosion of the mucous membrane in a portion of the duodenum. Evidence: TAS. Frequency: Occasional (HP:0040283). (ORPHA:263665)
- Gastric ulcer (HP:0002592): An ulcer, that is, an erosion of an area of the gastric mucous membrane. Evidence: TAS. Frequency: Occasional (HP:0040283). (ORPHA:263665)
- Abnormal gastric mucosa morphology (HP:0004295): An abnormality of the gastric mucous membrane. Evidence: TAS. Frequency: Occasional (HP:0040283). (ORPHA:263665)
- Intestinal polyp (HP:0005266): A discrete abnormal tissue mass that protrudes into the lumen of the intestine and is attached to the intestinal wall either by a stalk, pedunculus, or a broad base. Evidence: TAS. Frequency: Occasional (HP:0040283). (ORPHA:263665)
- Stercoral ulcer (HP:0012425): An ulcer of the colon due to pressure and irritation from retained fecal masses. Evidence: TAS. Frequency: Occasional (HP:0040283). (ORPHA:263665)